Phenotypes associated with the disease angioma serpiginosum, X-linked (OMIM:300652):
- Congenital onset (HP:0003577): A phenotypic abnormality that is present at birth. Evidence: IEA. (OMIM:300652)
- Fine hair (HP:0002213): Hair that is fine or thin to the touch. Evidence: PCS. (OMIM:300652)
- X-linked dominant inheritance (HP:0001423): A mode of inheritance that is observed for dominant traits related to a gene encoded on the X chromosome. In the context of medical genetics, X-linked dominant disorders tend to manifest very severely in affected males. The severity of manifestation in females may depend on the degree of skewed X inactivation. Evidence: IEA. (OMIM:300652)
- Nail dystrophy (HP:0008404): Onychodystrophy (nail dystrophy) refers to nail changes apart from changes of the color (nail dyschromia) and involves partial or complete disruption of the various keratinous layers of the nail plate. Evidence: TAS. (OMIM:300652)
- Sparse hair (HP:0008070): Reduced density of hairs. Evidence: TAS. (OMIM:300652)
- Slowly progressive (HP:0003677): Applies to a disease manifestation that only slowly increases in scope or severity over the course of time. Evidence: IEA. (OMIM:300652)
- Hyperkeratosis (HP:0000962): Hyperkeratosis is a histopathological term defining a thickened stratum corneum and may be present in many different skin conditions, with many possible overlaps. Hyperkeratosis refers to the increased thickness of the stratum corneum, the outer layer of the skin. Hyperkeratosis is subclassified as orthokeratotic or parakeratotic. Orthokeratotic hyperkeratosis refers to the thickening of the keratin layer with preserved keratinocyte maturation, while parakeratotic hyperkeratosis shows retained nuclei as a sign of delayed maturation of keratinocytes. Evidence: TAS. Frequency: 20/20. (OMIM:300652)